- Abnormality of the voice (HP:0001608). Evidence: TAS. Frequency: Frequent (HP:0040282). (ORPHA:99977)
- Clinodactyly of the 5th toe (HP:0001864): Bending or curvature of a fifth toe in the tibial direction (i.e., towards the big toe). Evidence: TAS. Frequency: Very frequent (HP:0040281). (ORPHA:99977)
- Nausea and vomiting (HP:0002017): Nausea is a commonly encountered symptom that has been defined as an unpleasant painless subjective feeling that one will imminently vomit. Vomiting has been defined as the forceful expulsion of the contents of the stomach, duodenum, or jejunum through the oral cavity. While nausea and vomiting are often thought to exist on a temporal continuum, this is not always the case. There are situations when severe nausea may be present without emesis and less frequently, when emesis may be present without preceding nausea. Evidence: TAS. Frequency: Frequent (HP:0040282). (ORPHA:99977)
- Lymphadenopathy (HP:0002716): Enlargement (swelling) of a lymph node. Evidence: TAS. Frequency: Occasional (HP:0040283). (ORPHA:99977)
- Feeding difficulties in infancy (HP:0008872): Impaired feeding performance of an infant as manifested by difficulties such as weak and ineffective sucking, brief bursts of sucking, and falling asleep during sucking. There may be difficulties with chewing or maintaining attention. Evidence: TAS. Frequency: Very frequent (HP:0040281). (ORPHA:99977)
- Esophageal carcinoma (HP:0011459): The presence of a carcinoma of the esophagus. Evidence: TAS. Frequency: Very frequent (HP:0040281). (ORPHA:99977)
- Cough (HP:0012735): A sudden, audible expulsion of air from the lungs through a partially closed glottis, preceded by inhalation. Evidence: TAS. Frequency: Frequent (HP:0040282). (ORPHA:99977)
- Chest pain (HP:0100749): An unpleasant sensation characterized by physical discomfort (such as pricking, throbbing, or aching) localized to the chest. Evidence: TAS. Frequency: Frequent (HP:0040282). (ORPHA:99977)
These phenotypes are associated with the disease Squamous cell carcinoma of the esophagus (ORPHA:99977).